Phenotypes associated with the disease Spinocerebellar ataxia type 5 (ORPHA:98766):
- Cerebellar atrophy (HP:0001272): Cerebellar atrophy is defined as a cerebellum with initially normal structures, in a posterior fossa with normal size, which displays enlarged fissures (interfolial spaces) in comparison to the foliae secondary to loss of tissue. Cerebellar atrophy implies irreversible loss of tissue and result from an ongoing progressive disease until a final stage is reached or a single injury, e.g. an intoxication or infectious event. Evidence: TAS. Frequency: Very frequent (HP:0040281). (ORPHA:98766)
- Gait disturbance (HP:0001288): The term gait disturbance can refer to any disruption of the ability to walk. Evidence: TAS. Frequency: Very frequent (HP:0040281). (ORPHA:98766)
- Slurred speech (HP:0001350): Abnormal coordination of muscles involved in speech. Evidence: TAS. Frequency: Very frequent (HP:0040281). (ORPHA:98766)
- Incoordination (HP:0002311): A deficit in coordination of muscle movements. Coordination is defined as the orchestrated movement of multiple body parts as required to accomplish intended actions, like walking. Evidence: TAS. Frequency: Very frequent (HP:0040281). (ORPHA:98766)